Phenotypes associated with the disease Aniridia-intellectual disability syndrome (ORPHA:1068):
- Cataract (HP:0000518): A cataract is an opacity or clouding that develops in the crystalline lens of the eye or in its capsule. Evidence: TAS. Frequency: Very frequent (HP:0040281). (ORPHA:1068)
- Aniridia (HP:0000526): Abnormality of the iris characterized by, typically bilateral, complete or partial iris hypoplasia. The phenotype ranges from mild defects of anterior iris stroma only to almost complete absence of the iris. Evidence: TAS. Frequency: Very frequent (HP:0040281). (ORPHA:1068)
- Optic nerve hypoplasia (HP:0000609): Underdevelopment of the optic nerve. Evidence: TAS. Frequency: Very frequent (HP:0040281). (ORPHA:1068)
- Ectopia lentis (HP:0001083): Dislocation or malposition of the crystalline lens of the eye. A partial displacement (or dislocation) of the lens is described as a subluxation of the lens, while a complete displacement is termed luxation of the lens. A complete displacement occurs if the lens is completely outside the patellar fossa of the lens, either in the anterior chamber, in the vitreous, or directly on the retina. If the lens is partially displaced but still contained within the lens space, then it is termed subluxation. Evidence: TAS. Frequency: Very frequent (HP:0040281). (ORPHA:1068)
- Moderate intellectual disability (HP:0002342): Moderate intellectual disability (ID) is defined as a type of ID characterized by moderately sub-average adaptive functioning and intellectual functioning, with an intelligence quotient (IQ) the range of 35-49. Evidence: TAS. Frequency: Very frequent (HP:0040281). (ORPHA:1068)